- Juvenile onset (HP:0003621): Onset of signs or symptoms of disease between the age of 5 and 15 years. Evidence: PCS. (PMID:11709538)
- Progressive sensorineural hearing impairment (HP:0000408): A progressive form of sensorineural hearing impairment. Evidence: PCS. (PMID:11709538)
- Low-frequency sensorineural hearing impairment (HP:0008573): A form of sensorineural hearing impairment that affects primarily the lower frequencies. Evidence: PCS. (PMID:11709538)
- Autosomal dominant inheritance (HP:0000006): A mode of inheritance that is observed for traits related to a gene encoded on one of the autosomes (i.e., the human chromosomes 1-22) in which a trait manifests in heterozygotes. In the context of medical genetics, an autosomal dominant disorder is caused when a single copy of the mutant allele is present. Males and females are affected equally, and can both transmit the disorder with a risk of 50% for each child of inheriting the mutant allele. Evidence: PCS. (PMID:11709538)
These phenotypes are associated with the disease autosomal dominant nonsyndromic hearing loss 6 (OMIM:600965).